- Pes cavus (HP:0001761): An increase in height of the medial longitudinal arch of the foot that does not flatten on weight bearing (i.e., a distinctly hollow form of the sole of the foot when it is bearing weight). Evidence: TAS. Frequency: Occasional (HP:0040283). (ORPHA:3041)
- Short toe (HP:0001831): A toe that appears disproportionately short compared to the foot. Evidence: TAS. Frequency: Occasional (HP:0040283). (ORPHA:3041)
- Metatarsus adductus (HP:0001840): The metatarsals are deviated medially (tibially), that is, the bones in the front half of the foot bend or turn in toward the body. Evidence: TAS. Frequency: Occasional (HP:0040283). (ORPHA:3041)
- Truncal obesity (HP:0001956): Obesity located preferentially in the trunk of the body as opposed to the extremities. Evidence: TAS. Frequency: Occasional (HP:0040283). (ORPHA:3041)
- Recurrent respiratory infections (HP:0002205): An increased susceptibility to respiratory infections as manifested by a history of recurrent respiratory infections. Evidence: TAS. Frequency: Occasional (HP:0040283). (ORPHA:3041)
- Spastic paraparesis (HP:0002313): Partial loss of the ability to move the lower limbs accompanied by spasticity of the lower limbs. Evidence: TAS. Frequency: Occasional (HP:0040283). (ORPHA:3041)
- Hand tremor (HP:0002378): An unintentional, oscillating to-and-fro muscle movement affecting the hand. Evidence: TAS. Frequency: Occasional (HP:0040283). (ORPHA:3041)
- Lumbar hyperlordosis (HP:0002938): An abnormal accentuation of the inward curvature of the spine in the lumbar region. Evidence: TAS. Frequency: Occasional (HP:0040283). (ORPHA:3041)
- Thoracic kyphosis (HP:0002942): Over curvature of the thoracic region, leading to a round back or if sever to a hump. Evidence: TAS. Frequency: Occasional (HP:0040283). (ORPHA:3041)
- Thoracolumbar scoliosis (HP:0002944). Evidence: TAS. Frequency: Occasional (HP:0040283). (ORPHA:3041)
- 2-3 toe syndactyly (HP:0004691): Syndactyly with fusion of toes two and three. Evidence: TAS. Frequency: Occasional (HP:0040283). (ORPHA:3041)
- 4-5 toe syndactyly (HP:0004692): Syndactyly with fusion of toes four and five. Evidence: TAS. Frequency: Occasional (HP:0040283). (ORPHA:3041)
- Flat occiput (HP:0005469): Reduced convexity of the occiput (posterior part of skull). Evidence: TAS. Frequency: Occasional (HP:0040283). (ORPHA:3041)
- Lumbar kyphosis in infancy (HP:0008414). Evidence: TAS. Frequency: Occasional (HP:0040283). (ORPHA:3041)
- Abnormal antihelix morphology (HP:0009738): An abnormality of the antihelix. Evidence: TAS. Frequency: Occasional (HP:0040283). (ORPHA:3041)
- Prominent forehead (HP:0011220): Forward prominence of the entire forehead, due to protrusion of the frontal bone. Evidence: TAS. Frequency: Occasional (HP:0040283). (ORPHA:3041)
- Midface retrusion (HP:0011800): Posterior positions and/or vertical shortening of the infraorbital and perialar regions, or increased concavity of the face and/or reduced nasolabial angle. Evidence: TAS. Frequency: Occasional (HP:0040283). (ORPHA:3041)
- Feeding difficulties (HP:0011968): Impaired ability to eat related to problems gathering food and getting ready to suck, chew, or swallow it. Evidence: TAS. Frequency: Occasional (HP:0040283). (ORPHA:3041)
- Flexion contracture of digit (HP:0030044): A bent (flexed) finger or toe joint that cannot be straightened actively or passively. It is thus a chronic loss of joint motion due to structural changes in muscle, tendons, ligaments, or skin that prevents normal movement of joints. Evidence: TAS. Frequency: Occasional (HP:0040283). (ORPHA:3041)
- Everted lower lip vermilion (HP:0000232): An abnormal configuration of the lower lip such that it is turned outward i.e., everted, with the Inner aspect of the lower lip vermilion (normally opposing the teeth) being visible in a frontal view. Evidence: TAS. Frequency: Very frequent (HP:0040281). (ORPHA:3041)
- Thin vermilion border (HP:0000233): Height of the vermilion of the medial part of the lip more than 2 SD below the mean, or apparently reduced height of the vermilion of the lip in the frontal view. The vermilion is the red part of the lips (and confusingly, the vermilion itself is also often referred to as being equivalent the lips). Evidence: TAS. Frequency: Very frequent (HP:0040281). (ORPHA:3041)
- High forehead (HP:0000348): An abnormally increased height of the forehead. Evidence: TAS. Frequency: Very frequent (HP:0040281). (ORPHA:3041)
- Broad nasal tip (HP:0000455): Increase in width of the nasal tip. Evidence: TAS. Frequency: Very frequent (HP:0040281). (ORPHA:3041)
- Deeply set eye (HP:0000490): An eye that is more deeply recessed into the plane of the face than is typical. Evidence: TAS. Frequency: Very frequent (HP:0040281). (ORPHA:3041)
- Upslanted palpebral fissure (HP:0000582): The palpebral fissure inclination is more than two standard deviations above the mean for age (objective); or, the inclination of the palpebral fissure is greater than typical for age. Evidence: TAS. Frequency: Very frequent (HP:0040281). (ORPHA:3041)
- Abnormal facial shape (HP:0001999): An abnormal morphology (form) of the face or its components. Evidence: TAS. Frequency: Very frequent (HP:0040281). (ORPHA:3041)
- Early balding (HP:0002234): Loss of scalp hair at an earlier than normal age. Evidence: TAS. Frequency: Very frequent (HP:0040281). (ORPHA:3041)
- Frontal balding (HP:0002292): Absence of hair in the anterior midline and/or parietal areas. Evidence: TAS. Frequency: Very frequent (HP:0040281). (ORPHA:3041)
- Acromesomelia (HP:0003086): Small hands and feet. Evidence: TAS. Frequency: Very frequent (HP:0040281). (ORPHA:3041)
- Severe intellectual disability (HP:0010864): Severe intellectual disability (ID) is defined as a type of ID characterized by severely sub-average adaptive functioning and intellectual functioning, with an intelligence quotient (IQ) the range of 20-34. Evidence: TAS. Frequency: Very frequent (HP:0040281). (ORPHA:3041)
- Micropenis (HP:0000054): Abnormally small penis. At birth, the normal penis is about 3 cm (stretched length from pubic tubercle to tip of penis) with micropenis less than 2.0-2.5 cm. Evidence: TAS. Frequency: Frequent (HP:0040282). (ORPHA:3041)
- Hypogonadism (HP:0000135): A decreased functionality of the gonad. Evidence: TAS. Frequency: Frequent (HP:0040282). (ORPHA:3041)
- Thin upper lip vermilion (HP:0000219): Height of the vermilion of the upper lip in the midline more than 2 SD below the mean. Alternatively, an apparently reduced height of the vermilion of the upper lip in the frontal view (subjective). Evidence: TAS. Frequency: Frequent (HP:0040282). (ORPHA:3041)
- Bulbous nose (HP:0000414): Increased volume and globular shape of the anteroinferior aspect of the nose. Evidence: TAS. Frequency: Frequent (HP:0040282). (ORPHA:3041)
- Blue irides (HP:0000635): A markedly blue coloration of the iris. Evidence: TAS. Frequency: Frequent (HP:0040282). (ORPHA:3041)
- Seizure (HP:0001250): A seizure is an intermittent abnormality of nervous system physiology characterized by a transient occurrence of signs and/or symptoms due to abnormal excessive or synchronous neuronal activity in the brain. Evidence: TAS. Frequency: Frequent (HP:0040282). (ORPHA:3041)
- Unsteady gait (HP:0002317). Evidence: TAS. Frequency: Frequent (HP:0040282). (ORPHA:3041)
- Kyphoscoliosis (HP:0002751): An abnormal curvature of the spine in both a coronal (lateral) and sagittal (back-to-front) plane. Evidence: TAS. Frequency: Frequent (HP:0040282). (ORPHA:3041)
- Patellar hypoplasia (HP:0003065): Underdevelopment of the patella. Evidence: TAS. Frequency: Frequent (HP:0040282). (ORPHA:3041)
- Decreased muscle mass (HP:0003199). Evidence: TAS. Frequency: Frequent (HP:0040282). (ORPHA:3041)
- External genital hypoplasia (HP:0003241): Underdevelopment of part or all of the external reproductive organs. Evidence: TAS. Frequency: Frequent (HP:0040282). (ORPHA:3041)
- Reduced subcutaneous adipose tissue (HP:0003758): A reduced amount of fat tissue in the lowest layer of the integument. This feature can be appreciated by a reduced skinfold thickness. Evidence: TAS. Frequency: Frequent (HP:0040282). (ORPHA:3041)
- Decreased testicular size (HP:0008734): Reduced volume of the testicle (the male gonad). Evidence: TAS. Frequency: Frequent (HP:0040282). (ORPHA:3041)
- Floppy infant (HP:0008947): Floppiness/hypotonia is defined as reduced resistance to passive movement of joints. Physical examination of floppy/hypotonic infants shows head lag, lack of shoulder and elbow muscle contraction on traction response, inability to tighten the shoulder girdle muscles (or slipping through) when held under the axillae, scarf sign (when the arm is pulled to the opposite side, the arm wraps around the neck with the elbow crossing midline), hyperdorsiflexion of the feet, easy apposition of the thumb against the forearm, feet touching the cheek with ease and without discomfort, frog leg position, and inverted U sign on ventral suspension (head, arms, and legs hanging down without elbow or knee flexion and the trunk rounded in a dome shape). Evidence: TAS. Frequency: Frequent (HP:0040282). (ORPHA:3041)
- Patellar subluxation (HP:0010499): The kneecap normally is located within the groove termed trochlea on the distal femur and can slide up and down in it. Patellar subluxation refers to an unstable kneecap that does not slide centrally within its groove, i.e., a partial dislocation of the patella. Evidence: TAS. Frequency: Frequent (HP:0040282). (ORPHA:3041)
- High palate (HP:0000218): Height of the palate more than 2 SD above the mean (objective) or palatal height at the level of the first permanent molar more than twice the height of the teeth (subjective). Evidence: TAS. Frequency: Occasional (HP:0040283). (ORPHA:3041)
- Dolichocephaly (HP:0000268): An abnormality of skull shape characterized by a increased anterior-posterior diameter, i.e., an increased antero-posterior dimension of the skull. Cephalic index less than 76%. Alternatively, an apparently increased antero-posterior length of the head compared to width. Often due to premature closure of the sagittal suture. Evidence: TAS. Frequency: Occasional (HP:0040283). (ORPHA:3041)
- Epicanthus (HP:0000286): A fold of skin starting above the medial aspect of the upper eyelid and arching downward to cover, pass in front of and lateral to the medial canthus. Evidence: TAS. Frequency: Occasional (HP:0040283). (ORPHA:3041)
- Short philtrum (HP:0000322): Distance between nasal base and midline upper lip vermilion border more than 2 SD below the mean. Alternatively, an apparently decreased distance between nasal base and midline upper lip vermilion border. Evidence: TAS. Frequency: Occasional (HP:0040283). (ORPHA:3041)
- Protruding ear (HP:0000411): Angle formed by the plane of the ear and the mastoid bone greater than the 97th centile for age (objective); or, outer edge of the helix more than 2 cm from the mastoid at the point of maximum distance (objective). Evidence: TAS. Frequency: Occasional (HP:0040283). (ORPHA:3041)
- Self-mutilation (HP:0000742): Deliberate harm to one's body resulting in tissue damage, without a conscious intent to die. Evidence: TAS. Frequency: Occasional (HP:0040283). (ORPHA:3041)
- Cafe-au-lait spot (HP:0000957): Cafe-au-lait spots are hyperpigmented lesions that can vary in color from light brown to dark brown with smooth borders and having a size of 1.5 cm or more in adults and 0.5 cm or more in children. Evidence: TAS. Frequency: Occasional (HP:0040283). (ORPHA:3041)
- Hyperextensibility of the finger joints (HP:0001187): The ability of the finger joints to move beyond their normal range of motion. Evidence: TAS. Frequency: Occasional (HP:0040283). (ORPHA:3041)
- Dysmetria (HP:0001310): A type of ataxia characterized by the inability to carry out movements with the correct range and motion across the plane of more than one joint related to incorrect estimation of the distances required for targeted movements. Evidence: TAS. Frequency: Occasional (HP:0040283). (ORPHA:3041)
These phenotypes are associated with the disease Intellectual disability-balding-patella luxation-acromicria syndrome (ORPHA:3041).